Phenotypes associated with the disease Banki syndrome (ORPHA:1228, an Orphanet rare-disease identifier):
- Brachydactyly (HP:0001156, a Human Phenotype Ontology term): Digits that appear disproportionately short compared to the hand/foot. The word brachydactyly is used here to describe a series distinct patterns of shortened digits (brachydactyly types A-E). This is the sense used here. Evidence: TAS. Frequency: Very frequent (HP:0040281, a Human Phenotype Ontology term). (ORPHA:1228)
- Clinodactyly of the 5th finger (HP:0004209, a Human Phenotype Ontology term): Clinodactyly refers to a bending or curvature of the fifth finger in the radial direction (i.e., towards the 4th finger). Evidence: TAS. Frequency: Very frequent (HP:0040281, a Human Phenotype Ontology term). (ORPHA:1228)
- Synostosis of carpal bones (HP:0005048, a Human Phenotype Ontology term). Evidence: TAS. Frequency: Very frequent (HP:0040281, a Human Phenotype Ontology term). (ORPHA:1228)
- Abnormal metacarpal morphology (HP:0005916, a Human Phenotype Ontology term): Any abnormal shape or structure of the metacarpal bones. Evidence: TAS. Frequency: Very frequent (HP:0040281, a Human Phenotype Ontology term). (ORPHA:1228)